Phenotypes associated with the disease NAIL HIGH-SULFUR PROTEIN (OMIM:161070):
- Abnormal nail morphology (HP:0001597): Abnormal structure or appearance of the nail. Evidence: IEA. (OMIM:161070)
- Autosomal dominant inheritance (HP:0000006): A mode of inheritance that is observed for traits related to a gene encoded on one of the autosomes (i.e., the human chromosomes 1-22) in which a trait manifests in heterozygotes. In the context of medical genetics, an autosomal dominant disorder is caused when a single copy of the mutant allele is present. Males and females are affected equally, and can both transmit the disorder with a risk of 50% for each child of inheriting the mutant allele. Evidence: IEA. (OMIM:161070)